- Strabismus (HP:0000486): A misalignment of the eyes so that the visual axes deviate from bifoveal fixation. The classification of strabismus may be based on a number of features including the relative position of the eyes, whether the deviation is latent or manifest, intermittent or constant, concomitant or otherwise and according to the age of onset and the relevance of any associated refractive error. Evidence: TAS. (OMIM:604219)
- Microcornea (HP:0000482): A congenital abnormality of the cornea in which the cornea and the anterior segment of the eye are smaller than normal. The horizontal diameter of the cornea does not reach 10 mm even in adulthood. Evidence: TAS. Frequency: Occasional (HP:0040283). (OMIM:604219)
- Cataract (HP:0000518): A cataract is an opacity or clouding that develops in the crystalline lens of the eye or in its capsule. Evidence: TAS. (OMIM:604219)
- Nystagmus (HP:0000639): Rhythmic, involuntary oscillations of one or both eyes related to abnormality in fixation, conjugate gaze, or vestibular mechanisms. Evidence: TAS. (OMIM:604219)
- Developmental cataract (HP:0000519): A cataract that occurs congenitally as the result of a developmental defect, in contrast to the majority of cataracts that occur in adulthood as the result of degenerative changes of the lens. Evidence: TAS. (OMIM:604219)
- Amblyopia (HP:0000646): Reduced visual acuity that is uncorrectable by lenses in the absence of detectable anatomic defects in the eye or visual pathways. Evidence: TAS. (OMIM:604219)
- Iris coloboma (HP:0000612): A coloboma of the iris. Evidence: TAS. Frequency: Occasional (HP:0040283). (OMIM:604219)
- Microphthalmia (HP:0000568): A developmental anomaly characterized by abnormal smallness of one or both eyes. Evidence: TAS. Frequency: Occasional (HP:0040283). (OMIM:604219)
- Autosomal recessive inheritance (HP:0000007): A mode of inheritance that is observed for traits related to a gene encoded on one of the autosomes (i.e., the human chromosomes 1-22) in which a trait manifests in individuals with two pathogenic alleles, either homozygotes (two copies of the same mutant allele) or compound heterozygotes (whereby each copy of a gene has a distinct mutant allele). Evidence: IEA. (OMIM:604219)
- Visual impairment (HP:0000505): Visual impairment (or vision impairment) is vision loss (of a person) to such a degree as to qualify as an additional support need through a significant limitation of visual capability resulting from either disease, trauma, or congenital or degenerative conditions that cannot be corrected by conventional means, such as refractive correction, medication, or surgery. Evidence: TAS. (OMIM:604219)
- Glaucoma (HP:0000501): Glaucoma refers loss of retinal ganglion cells in a characteristic pattern of optic neuropathy usually associated with increased intraocular pressure. Evidence: TAS. (OMIM:604219)
- Autosomal dominant inheritance (HP:0000006): A mode of inheritance that is observed for traits related to a gene encoded on one of the autosomes (i.e., the human chromosomes 1-22) in which a trait manifests in heterozygotes. In the context of medical genetics, an autosomal dominant disorder is caused when a single copy of the mutant allele is present. Males and females are affected equally, and can both transmit the disorder with a risk of 50% for each child of inheriting the mutant allele. Evidence: TAS. (OMIM:604219)
- Progressive cataract (HP:0007834): A kind of cataract that progresses with age. Evidence: TAS. Frequency: Occasional (HP:0040283). (OMIM:604219)
These phenotypes are associated with the disease cataract 9 multiple types (OMIM:604219).